- Macrocephaly (HP:0000256): Occipitofrontal (head) circumference greater than 97th centile compared to appropriate, age matched, sex-matched normal standards. Alternatively, a apparently increased size of the cranium. Evidence: TAS. Frequency: Frequent (HP:0040282). (ORPHA:544488)
- Hypertelorism (HP:0000316): Interpupillary distance more than 2 SD above the mean (alternatively, the appearance of an increased interpupillary distance or widely spaced eyes). Evidence: TAS. Frequency: Frequent (HP:0040282). (ORPHA:544488)
- Macrotia (HP:0000400): Median longitudinal ear length greater than two standard deviations above the mean and median ear width greater than two standard deviations above the mean (objective); or, apparent increase in length and width of the pinna (subjective). Evidence: TAS. Frequency: Frequent (HP:0040282). (ORPHA:544488)
- Bulbous nose (HP:0000414): Increased volume and globular shape of the anteroinferior aspect of the nose. Evidence: TAS. Frequency: Frequent (HP:0040282). (ORPHA:544488)
- Deeply set eye (HP:0000490): An eye that is more deeply recessed into the plane of the face than is typical. Evidence: TAS. Frequency: Frequent (HP:0040282). (ORPHA:544488)
- Sparse eyelashes (HP:0000653): Decreased density/number of eyelashes. Evidence: TAS. Frequency: Frequent (HP:0040282). (ORPHA:544488)
- Aggressive behavior (HP:0000718): Behavior or an act aimed at harming a person, animal, or physical property (e.g., acts of physical violence; shouting, swearing, and using harsh language; slashing someone's tires). Evidence: TAS. Frequency: Frequent (HP:0040282). (ORPHA:544488)
- Global developmental delay (HP:0001263): A delay in the achievement of motor or mental milestones in the domains of development of a child, including motor skills, speech and language, cognitive skills, and social and emotional skills. This term should only be used to describe children younger than five years of age. Evidence: TAS. Frequency: Frequent (HP:0040282). (ORPHA:544488)
- Neonatal hypotonia (HP:0001319): Muscular hypotonia (abnormally low muscle tone) manifesting in the neonatal period. Evidence: TAS. Frequency: Frequent (HP:0040282). (ORPHA:544488)
- Bilateral ptosis (HP:0001488). Evidence: TAS. Frequency: Frequent (HP:0040282). (ORPHA:544488)
- Large for gestational age (HP:0001520): The term large for gestational age applies to babies whose birth weight lies above the 90th percentile for that gestational age. Evidence: TAS. Frequency: Frequent (HP:0040282). (ORPHA:544488)
- Polyhydramnios (HP:0001561): The presence of excess amniotic fluid in the uterus during pregnancy. Evidence: TAS. Frequency: Frequent (HP:0040282). (ORPHA:544488)
- Small nail (HP:0001792): A nail that is diminished in length and width, i.e., underdeveloped nail. Evidence: TAS. Frequency: Frequent (HP:0040282). (ORPHA:544488)
- Large forehead (HP:0002003). Evidence: TAS. Frequency: Frequent (HP:0040282). (ORPHA:544488)
- Absent eyebrow (HP:0002223): Absence of the eyebrow. Evidence: TAS. Frequency: Frequent (HP:0040282). (ORPHA:544488)
- Attention deficit hyperactivity disorder (HP:0007018): Attention deficit hyperactivity disorder (ADHD) manifests at age 2-3 years or by first grade at the latest. The main symptoms are distractibility, impulsivity, hyperactivity, and often trouble organizing tasks and projects, difficulty going to sleep, and social problems from being aggressive, loud, or impatient. Evidence: TAS. Frequency: Frequent (HP:0040282). (ORPHA:544488)
- Bilateral cryptorchidism (HP:0008689): Absence of both testes from the scrotum owing to failure of the testis or testes to descend through the inguinal canal to the scrotum. Evidence: TAS. Frequency: Frequent (HP:0040282). (ORPHA:544488)
- Dilation of Virchow-Robin spaces (HP:0012520): Increased dimensions of the Virchow-Robin spaces (also known as perivascular spaces), which surround the walls of vessels as they course from the subarachnoid space through the brain parenchyma. Perivascular spaces are commonly microscopic, and not visible on conventional neuroimaging. This term refers to an increase of size of these spaces such that they are visible on neuroimaging (usually magnetic resonance imaging). The dilatations are regular cavities that always contain a patent artery. Evidence: TAS. Frequency: Frequent (HP:0040282). (ORPHA:544488)
- Hyperintensity of cerebral white matter on MRI (HP:0030890): A brighter than expected signal on magnetic resonance imaging emanating from the cerebral white matter. Evidence: TAS. Frequency: Frequent (HP:0040282). (ORPHA:544488)
- Inguinal hernia (HP:0000023): Protrusion of the contents of the abdominal cavity through the inguinal canal. Evidence: TAS. Frequency: Occasional (HP:0040283). (ORPHA:544488)
- Retrognathia (HP:0000278): An abnormality in which the mandible is mislocalised posteriorly. Evidence: TAS. Frequency: Occasional (HP:0040283). (ORPHA:544488)
- Broad forehead (HP:0000337): Width of the forehead or distance between the frontotemporales is more than two standard deviations above the mean (objective); or apparently increased distance between the two sides of the forehead. Evidence: TAS. Frequency: Occasional (HP:0040283). (ORPHA:544488)
- Preauricular skin tag (HP:0000384): A rudimentary tag of skin often containing ear tissue including a core of cartilage and located just anterior to the auricle (outer part of the ear). Evidence: TAS. Frequency: Occasional (HP:0040283). (ORPHA:544488)
- Sensorineural hearing impairment (HP:0000407): A type of hearing impairment in one or both ears related to an abnormal functionality of the cochlear nerve. Evidence: TAS. Frequency: Occasional (HP:0040283). (ORPHA:544488)
- Downslanted palpebral fissures (HP:0000494): The palpebral fissure inclination is more than two standard deviations below the mean. Evidence: TAS. Frequency: Occasional (HP:0040283). (ORPHA:544488)
- Absent eyelashes (HP:0000561): Lack of eyelashes. Evidence: TAS. Frequency: Occasional (HP:0040283). (ORPHA:544488)
- Blepharophimosis (HP:0000581): A fixed reduction in the vertical distance between the upper and lower eyelids with short palpebral fissures. Evidence: TAS. Frequency: Occasional (HP:0040283). (ORPHA:544488)
- Atypical behavior (HP:0000708): Atypical behavior is an abnormality in a person's actions that can be controlled or modulated by the will of the individual. While abnormal behaviors can be difficult to control, they are distinct from other abnormal actions that cannot be affected by the individual's will. Evidence: TAS. Frequency: Occasional (HP:0040283). (ORPHA:544488)
- Rib fusion (HP:0000902): Complete or partial merging of adjacent ribs. Evidence: TAS. Frequency: Occasional (HP:0040283). (ORPHA:544488)
- Sacral dimple (HP:0000960): A cutaneous indentation resulting from tethering of the skin to underlying structures (bone) of the intergluteal cleft. Evidence: TAS. Frequency: Occasional (HP:0040283). (ORPHA:544488)
- Tapered finger (HP:0001182): The gradual reduction in girth of the finger from proximal to distal. Evidence: TAS. Frequency: Occasional (HP:0040283). (ORPHA:544488)
- Seizure (HP:0001250): A seizure is an intermittent abnormality of nervous system physiology characterized by a transient occurrence of signs and/or symptoms due to abnormal excessive or synchronous neuronal activity in the brain. Evidence: TAS. Frequency: Occasional (HP:0040283). (ORPHA:544488)
- Spasticity (HP:0001257): A motor disorder characterized by a velocity-dependent increase in tonic stretch reflexes with increased muscle tone, exaggerated (hyperexcitable) tendon reflexes. Evidence: TAS. Frequency: Occasional (HP:0040283). (ORPHA:544488)
- Absent speech (HP:0001344): Complete lack of development of speech and language abilities. Evidence: TAS. Frequency: Occasional (HP:0040283). (ORPHA:544488)
- Alopecia (HP:0001596): A noncongenital process of hair loss, which may progress to partial or complete baldness. Evidence: TAS. Frequency: Occasional (HP:0040283). (ORPHA:544488)
- Hypoplastic toenails (HP:0001800): Underdevelopment of the toenail. Evidence: TAS. Frequency: Occasional (HP:0040283). (ORPHA:544488)
- Asthma (HP:0002099): Asthma is characterized by increased responsiveness of the tracheobronchial tree to multiple stimuli, leading to narrowing of the air passages with resultant dyspnea, cough, and wheezing. Evidence: TAS. Frequency: Occasional (HP:0040283). (ORPHA:544488)
- Sparse scalp hair (HP:0002209): Decreased number of hairs per unit area of skin of the scalp. Evidence: TAS. Frequency: Occasional (HP:0040283). (ORPHA:544488)
- Abnormal cerebellar vermis morphology (HP:0002334): An anomaly of the vermis of cerebellum. Evidence: TAS. Frequency: Occasional (HP:0040283). (ORPHA:544488)
- Poor speech (HP:0002465). Evidence: TAS. Frequency: Occasional (HP:0040283). (ORPHA:544488)
- Celiac disease (HP:0002608): Celiac disease (CD) is an autoimmune condition affecting the small intestine, triggered by the ingestion of gluten, the protein fraction of wheat, barley, and rye. Clinical manifestations of CD are highly variable and include both gastrointestinal and non-gastrointestinal features. The hallmark of CD is an immune-mediated enteropathy. This term is included because the occurrence of CD is seen as a feature of a number of other diseases. Evidence: TAS. Frequency: Occasional (HP:0040283). (ORPHA:544488)
- Clinodactyly of the 5th finger (HP:0004209): Clinodactyly refers to a bending or curvature of the fifth finger in the radial direction (i.e., towards the 4th finger). Evidence: TAS. Frequency: Occasional (HP:0040283). (ORPHA:544488)
- Lateral ventricle dilatation (HP:0006956). Evidence: TAS. Frequency: Occasional (HP:0040283). (ORPHA:544488)
- Dysplastic corpus callosum (HP:0006989): Dysplasia and dysgenesis of the corpus callosum are nonspecific descriptions that imply defective development of the corpus callosum. The term dysplasia is applied when the morphology of the corpus callosum is altered as a congenital trait. For instance, the corpus callosum may be hump-shaped, kinked, or a striped corpus callosum that lacks an anatomically distinct genu and splenium. Evidence: TAS. Frequency: Occasional (HP:0040283). (ORPHA:544488)
- Thick corpus callosum (HP:0007074): Increased vertical dimension of the corpus callosum. This feature can be visualized by sagittal sections on magnetic resonance tomography imaging of the brain. Evidence: TAS. Frequency: Occasional (HP:0040283). (ORPHA:544488)
- Dilated third ventricle (HP:0007082): An increase in size of the third ventricle. Evidence: TAS. Frequency: Occasional (HP:0040283). (ORPHA:544488)
- Periventricular cysts (HP:0007109). Evidence: TAS. Frequency: Occasional (HP:0040283). (ORPHA:544488)
- Increased nuchal translucency (HP:0010880): Nuchal translucency is the sonographic appearance of subcutaneous accumulation of liquid in the back of the fetal neck in the first trimester of pregnancy (11-14 gestational weeks of pregnancy). Evidence: TAS. Frequency: Occasional (HP:0040283). (ORPHA:544488)
- Vascular skin abnormality (HP:0011276). Evidence: TAS. Frequency: Occasional (HP:0040283). (ORPHA:544488)
- Tapered toe (HP:0011309): The gradual reduction in girth of the toe from proximal to distal. Evidence: TAS. Frequency: Occasional (HP:0040283). (ORPHA:544488)
- Chronic constipation (HP:0012450): Constipation for longer than three months with fewer than 3 bowel movements per week, straining, lumpy or hard stools, and a sensation of anorectal obstruction or incomplete defecation. Evidence: TAS. Frequency: Occasional (HP:0040283). (ORPHA:544488)
- Keratosis pilaris (HP:0032152): An anomaly of the hair follicles of the skin that typically presents as small, rough, brown folliculocentric papules distributed over characteristic areas of the skin, particularly the outer-upper arms and thighs. Evidence: TAS. Frequency: Occasional (HP:0040283). (ORPHA:544488)
- Non-convulsive status epilepticus without coma (HP:0032671): A type of status epilepticus without prominent motor symptoms in the absence of coma. Evidence: TAS. Frequency: Occasional (HP:0040283). (ORPHA:544488)
- Sparse eyebrow (HP:0045075): Decreased density/number of eyebrow hairs. Evidence: TAS. Frequency: Occasional (HP:0040283). (ORPHA:544488)
- Self-injurious behavior (HP:0100716): Self-aggression. Evidence: TAS. Frequency: Occasional (HP:0040283). (ORPHA:544488)
- Recurrent ear infections (HP:0410018): Increased susceptibility to ear infections as manifested by recurrent episodes of ear infections. Evidence: TAS. Frequency: Occasional (HP:0040283). (ORPHA:544488)
These phenotypes are associated with the disease Global developmental delay-alopecia-macrocephaly-facial dysmorphism-structural brain anomalies syndrome (ORPHA:544488).